Phenotypes associated with the disease ureter, bifid or double (OMIM:191550):
- Ureteral duplication (HP:0000073): A developmental anomaly characterized by the presence of two, instead of one, ureter connecting a kidney to the bladder. Evidence: IEA. (OMIM:191550)
- Autosomal dominant inheritance (HP:0000006): A mode of inheritance that is observed for traits related to a gene encoded on one of the autosomes (i.e., the human chromosomes 1-22) in which a trait manifests in heterozygotes. In the context of medical genetics, an autosomal dominant disorder is caused when a single copy of the mutant allele is present. Males and females are affected equally, and can both transmit the disorder with a risk of 50% for each child of inheriting the mutant allele. Evidence: IEA. (OMIM:191550)